Phenotypes associated with the disease intellectual developmental disorder with dysmorphic facies and ptosis (OMIM:617333):
- Congenital onset (HP:0003577): A phenotypic abnormality that is present at birth. Evidence: PCS. Frequency: 10/10. (PMID:27939640)
- Long philtrum (HP:0000343): Distance between nasal base and midline upper lip vermilion border more than 2 SD above the mean. Alternatively, an apparently increased distance between nasal base and midline upper lip vermilion border. Evidence: PCS. Frequency: 10/20. (PMID:27939640;OMIM:617333)
- Strabismus (HP:0000486): A misalignment of the eyes so that the visual axes deviate from bifoveal fixation. The classification of strabismus may be based on a number of features including the relative position of the eyes, whether the deviation is latent or manifest, intermittent or constant, concomitant or otherwise and according to the age of onset and the relevance of any associated refractive error. Evidence: PCS. Frequency: 2/10. (PMID:27939640)
- Short stature (HP:0004322): A height below that which is expected according to age and gender norms. Although there is no universally accepted definition of short stature, many refer to "short stature" as height more than 2 standard deviations below the mean for age and gender (or below the 3rd percentile for age and gender dependent norms). Evidence: PCS. Frequency: 2/20. (PMID:27939640;OMIM:617333)
- Seizure (HP:0001250): A seizure is an intermittent abnormality of nervous system physiology characterized by a transient occurrence of signs and/or symptoms due to abnormal excessive or synchronous neuronal activity in the brain. Evidence: PCS. Frequency: 5/10. (PMID:27939640)
- Narrow mouth (HP:0000160): Distance between the commissures of the mouth more than 2 SD below the mean. Alternatively, an apparently decreased width of the oral aperture (subjective). Evidence: PCS. Frequency: 3/10. (PMID:27939640)
- Blepharophimosis (HP:0000581): A fixed reduction in the vertical distance between the upper and lower eyelids with short palpebral fissures. Evidence: PCS. Frequency: 4/8. (PMID:27939640)
- Hypotonia (HP:0001252): Hypotonia is an abnormally low muscle tone (the amount of tension or resistance to movement in a muscle). Even when relaxed, muscles have a continuous and passive partial contraction which provides some resistance to passive stretching. Hypotonia thus manifests as diminished resistance to passive stretching. Hypotonia is not the same as muscle weakness, although the two conditions can co-exist. Evidence: PCS. Frequency: 7/8. (PMID:27939640)
- Delayed fine motor development (HP:0010862): A type of motor delay characterized by a delay in acquiring the ability to control the fingers and hands. Evidence: PCS. Frequency: 6/8. (PMID:27939640)
- Flat face (HP:0012368): Absence of concavity or convexity of the face when viewed in profile. Evidence: PCS. Frequency: 7/9. (PMID:27939640)
- Thin corpus callosum (HP:0033725): An abnormally thin corpus callous, due to atrophy, hypoplasia or agenesis. This term is intended to be used in situations where it is not known if thinning of the corpus callosum (for instance, as visualized by magnetic resonance tomography) is due to abnormal development (e.g. a leukodystrophy) or atrophy following normal development (e.g. neurodegeneration). Evidence: PCS. Frequency: 1/7. (PMID:27939640)
- Hypertelorism (HP:0000316): Interpupillary distance more than 2 SD above the mean (alternatively, the appearance of an increased interpupillary distance or widely spaced eyes). Evidence: PCS. Frequency: 9/10. (PMID:27939640)
- Broad forehead (HP:0000337): Width of the forehead or distance between the frontotemporales is more than two standard deviations above the mean (objective); or apparently increased distance between the two sides of the forehead. Evidence: PCS. Frequency: 3/10. (PMID:27939640)
- Downturned corners of mouth (HP:0002714): A morphological abnormality of the mouth in which the angle of the mouth is downturned. The oral commissures are positioned inferior to the midline labial fissure. Evidence: PCS. Frequency: 1/10. (PMID:27939640)
- Round face (HP:0000311): The facial appearance is more circular than usual as viewed from the front. Evidence: PCS. Frequency: 7/10. (PMID:27939640)
- Intellectual disability (HP:0001249): The term intellectual disability or intellectual developmental disorder is used to describe significantly sub-average intellectual and adaptive functioning based on clinical assessment and as measured by individually administered, appropriately normed, standardized and validated tests of intellectual functioning and adaptive behavior, with onset during the developmental period from infancy through adolescence. Evidence: PCS. Frequency: 6/8. (PMID:27939640)
- Neonatal onset (HP:0003623): Onset of signs or symptoms of disease within the first 28 days of life. Evidence: PCS. Frequency: 4/4. (PMID:27939640)
- Wide mouth (HP:0000154): Distance between the oral commissures more than 2 SD above the mean. Alternatively, an apparently increased width of the oral aperture (subjective). Evidence: PCS. Frequency: 1/10. (PMID:27939640)
- Downslanted palpebral fissures (HP:0000494): The palpebral fissure inclination is more than two standard deviations below the mean. Evidence: PCS. Frequency: 4/10. (PMID:27939640)
- Microcephaly (HP:0000252): Head circumference below 2 standard deviations below the mean for age and gender. Evidence: PCS. Frequency: 1/10. (PMID:27939640)
- Delayed speech and language development (HP:0000750): A degree of language development that is significantly below the norm for a child of a specified age. Evidence: PCS. Frequency: 10/10. (PMID:27939640)
- Talipes equinovarus (HP:0001762): Talipes equinovarus (also called clubfoot) typically has four main components: inversion and adduction of the forefoot; inversion of the heel and hindfoot; equinus (limitation of extension) of the ankle and subtalar joint; and internal rotation of the leg. Evidence: PCS. Frequency: 10/20. (PMID:27939640;OMIM:617333)
- Wide nasal bridge (HP:0000431): Increased breadth of the nasal bridge (and with it, the nasal root). Evidence: PCS. Frequency: 9/10. (PMID:27939640)
- Delayed ability to walk (HP:0031936): A failure to achieve the ability to walk at an appropriate developmental stage. Most children learn to walk in a series of stages, and learn to walk short distances independently between 12 and 15 months. Evidence: PCS. Frequency: 5/9. (PMID:27939640)
- Feeding difficulties (HP:0011968): Impaired ability to eat related to problems gathering food and getting ready to suck, chew, or swallow it. Evidence: PCS. Frequency: 4/10. (PMID:27939640)
- Joint hypermobility (HP:0001382): The capability that a joint (or a group of joints) has to move, passively and/or actively, beyond normal limits along physiological axes. Evidence: PCS. Frequency: 6/10. (PMID:27939640)
- Global developmental delay (HP:0001263): A delay in the achievement of motor or mental milestones in the domains of development of a child, including motor skills, speech and language, cognitive skills, and social and emotional skills. This term should only be used to describe children younger than five years of age. Evidence: PCS. Frequency: 10/10. (PMID:27939640)
- Delayed gross motor development (HP:0002194): A type of motor delay characterized by a delay in acquiring the ability to control the large muscles of the body for walking, running, sitting, and crawling. Evidence: PCS. Frequency: 9/10. (PMID:27939640)
- Camptodactyly (HP:0012385): The distal interphalangeal joint and/or the proximal interphalangeal joint of the fingers or toes cannot be extended to 180 degrees by either active or passive extension. Evidence: TAS. (OMIM:617333)
- Reduced cerebral white matter volume (HP:0034295): An abnormally low volume of the white matter of the brain. Evidence: PCS. Frequency: 2/10. (PMID:27939640)
- Ptosis (HP:0000508): The upper eyelid margin is positioned 3 mm or more lower than usual and covers the superior portion of the iris (objective); or, the upper lid margin obscures at least part of the pupil (subjective). Evidence: PCS. Frequency: 6/10. (PMID:27939640)
- Hyperintensity of cerebral white matter on MRI (HP:0030890): A brighter than expected signal on magnetic resonance imaging emanating from the cerebral white matter. Evidence: PCS. Frequency: 1/7. (PMID:27939640)
- Intrauterine growth retardation (HP:0001511): An abnormal restriction of fetal growth with fetal weight below the tenth percentile for gestational age. Evidence: PCS. Frequency: 2/20. (PMID:27939640;OMIM:617333)
- Growth delay (HP:0001510): A deficiency or slowing down of growth pre- and postnatally. Evidence: TAS. Frequency: Occasional (HP:0040283). (OMIM:617333)
- Short philtrum (HP:0000322): Distance between nasal base and midline upper lip vermilion border more than 2 SD below the mean. Alternatively, an apparently decreased distance between nasal base and midline upper lip vermilion border. Evidence: PCS. Frequency: 3/10. (PMID:27939640)
- Autosomal dominant inheritance (HP:0000006): A mode of inheritance that is observed for traits related to a gene encoded on one of the autosomes (i.e., the human chromosomes 1-22) in which a trait manifests in heterozygotes. In the context of medical genetics, an autosomal dominant disorder is caused when a single copy of the mutant allele is present. Males and females are affected equally, and can both transmit the disorder with a risk of 50% for each child of inheriting the mutant allele. Evidence: PCS. (PMID:27939640)
- Cervical C2/C3 vertebral fusion (HP:0004602): Fusion of cervical vertebrae at C2 and C3, caused by a failure in the normal segmentation or division of the cervical vertebrae during the early weeks of fetal development, leading to a short neck with a low hairline at the back of the head, and restricted mobility of the upper spine. Evidence: PCS. Frequency: 3/10. (PMID:27939640)
- Low-set ears (HP:0000369): Upper insertion of the ear to the scalp below an imaginary horizontal line drawn between the inner canthi of the eye and extending posteriorly to the ear. Evidence: PCS. Frequency: 2/10. (PMID:27939640)